- Abnormal nail morphology (HP:0001597): Abnormal structure or appearance of the nail. Evidence: IEA. (OMIM:152600)
- Autosomal dominant inheritance (HP:0000006): A mode of inheritance that is observed for traits related to a gene encoded on one of the autosomes (i.e., the human chromosomes 1-22) in which a trait manifests in heterozygotes. In the context of medical genetics, an autosomal dominant disorder is caused when a single copy of the mutant allele is present. Males and females are affected equally, and can both transmit the disorder with a risk of 50% for each child of inheriting the mutant allele. Evidence: IEA. (OMIM:152600)
These phenotypes are associated with the disease LUNULAE OF FINGERNAILS (OMIM:152600).